- Retinal degeneration (HP:0000546): A nonspecific term denoting progressive loss of the retinal pigment epithelium (RPE) and/or neurosensory retinal cells. Evidence: TAS. Frequency: Very frequent (HP:0040281). (ORPHA:3363)
- Hypogonadism (HP:0000135): A decreased functionality of the gonad. Evidence: TAS. Frequency: Frequent (HP:0040282). (ORPHA:3363)
- Long eyelashes (HP:0000527): Mid upper eyelash length >10 mm or increased length of the eyelashes (subjective). Evidence: TAS. Frequency: Frequent (HP:0040282). (ORPHA:3363)
- Pigmentary retinopathy (HP:0000580): An abnormality of the retina characterized by pigment deposition. It is typically associated with migration and proliferation of macrophages or retinal pigment epithelial cells into the retina; melanin from these cells causes the pigmentary changes. Pigmentary retinopathy is a common final pathway of many retinal conditions and is often associated with visual loss. Evidence: TAS. Frequency: Frequent (HP:0040282). (ORPHA:3363)
- Hypothyroidism (HP:0000821): Deficiency of thyroid hormone. Evidence: TAS. Frequency: Frequent (HP:0040282). (ORPHA:3363)
- Decreased response to growth hormone stimulation test (HP:0000824): Insufficient responses to growth hormone (GH) provocation tests. GH deficiency is defined as a serum peak GH concentration less than 10 ng/mL on provocation with a combination of at least two separate stimulation tests. Evidence: TAS. Frequency: Frequent (HP:0040282). (ORPHA:3363)
- Intellectual disability (HP:0001249): The term intellectual disability or intellectual developmental disorder is used to describe significantly sub-average intellectual and adaptive functioning based on clinical assessment and as measured by individually administered, appropriately normed, standardized and validated tests of intellectual functioning and adaptive behavior, with onset during the developmental period from infancy through adolescence. Evidence: TAS. Frequency: Frequent (HP:0040282). (ORPHA:3363)
- Ataxia (HP:0001251): Ataxia refers to impaired coordination of voluntary muscle movement. Cerebellar ataxia refers to ataxia due to dysfunction of the cerebellum. This causes a variety of elementary neurological deficits including asynergy (lack of coordination between muscles, limbs and joints), dysmetria (lack of ability to judge distances that can lead to under- or overshoot in grasping movements), and dysdiadochokinesia (inability to perform rapid movements requiring antagonizing muscle groups to be switched on and off repeatedly). Evidence: TAS. Frequency: Frequent (HP:0040282). (ORPHA:3363)
- Growth delay (HP:0001510): A deficiency or slowing down of growth pre- and postnatally. Evidence: TAS. Frequency: Frequent (HP:0040282). (ORPHA:3363)
- Small for gestational age (HP:0001518): Smaller than normal size according to sex and gestational age related norms, defined as a weight below the 10th percentile for the gestational age. Evidence: TAS. Frequency: Frequent (HP:0040282). (ORPHA:3363)
- Alopecia (HP:0001596): A noncongenital process of hair loss, which may progress to partial or complete baldness. Evidence: TAS. Frequency: Frequent (HP:0040282). (ORPHA:3363)
- Delayed skeletal maturation (HP:0002750): A decreased rate of skeletal maturation. Delayed skeletal maturation can be diagnosed on the basis of an estimation of the bone age from radiographs of specific bones in the human body. Evidence: TAS. Frequency: Frequent (HP:0040282). (ORPHA:3363)
- Neonatal hyperbilirubinemia (HP:0003265): A type of hyperbilirubinemia with neonatal onset. Evidence: TAS. Frequency: Frequent (HP:0040282). (ORPHA:3363)
- Sparse hair (HP:0008070): Reduced density of hairs. Evidence: TAS. Frequency: Frequent (HP:0040282). (ORPHA:3363)
- Peripheral neuropathy (HP:0009830): Peripheral neuropathy is a general term for any disorder of the peripheral nervous system. The main clinical features used to classify peripheral neuropathy are distribution, type (mainly demyelinating versus mainly axonal), duration, and course. Evidence: TAS. Frequency: Frequent (HP:0040282). (ORPHA:3363)
- Cryptorchidism (HP:0000028): Testis in inguinal canal. That is, absence of one or both testes from the scrotum owing to failure of the testis or testes to descend through the inguinal canal to the scrotum. Evidence: TAS. Frequency: Occasional (HP:0040283). (ORPHA:3363)
- Micropenis (HP:0000054): Abnormally small penis. At birth, the normal penis is about 3 cm (stretched length from pubic tubercle to tip of penis) with micropenis less than 2.0-2.5 cm. Evidence: TAS. Frequency: Occasional (HP:0040283). (ORPHA:3363)
- Abnormality of the dentition (HP:0000164): Any abnormality of the teeth. Evidence: TAS. Frequency: Occasional (HP:0040283). (ORPHA:3363)
- Myopia (HP:0000545): An abnormality of refraction characterized by the ability to see objects nearby clearly, while objects in the distance appear blurry. Evidence: TAS. Frequency: Occasional (HP:0040283). (ORPHA:3363)
- Frontal bossing (HP:0002007): Bilateral bulging of the lateral frontal bone prominences with relative sparing of the midline. Evidence: TAS. Frequency: Occasional (HP:0040283). (ORPHA:3363)
- Microcephaly (HP:0000252): Head circumference below 2 standard deviations below the mean for age and gender. Evidence: TAS. Frequency: Very rare (HP:0040284). (ORPHA:3363)
- Seizure (HP:0001250): A seizure is an intermittent abnormality of nervous system physiology characterized by a transient occurrence of signs and/or symptoms due to abnormal excessive or synchronous neuronal activity in the brain. Evidence: TAS. Frequency: Very rare (HP:0040284). (ORPHA:3363)
These phenotypes are associated with the disease Trichomegaly-retina pigmentary degeneration-dwarfism syndrome (ORPHA:3363).